- Hyporeflexia (HP:0001265): Reduction of neurologic reflexes such as the knee-jerk reaction. Evidence: IEA. (OMIM:607791)
- Axonal degeneration/regeneration (HP:0003378): A pattern of simultaneous degeneration and regeneration of axons (see comment). Evidence: IEA. (OMIM:607791)
- Distal amyotrophy (HP:0003693): Muscular atrophy affecting muscles in the distal portions of the extremities. Evidence: TAS. (OMIM:607791)
- Upper limb muscle weakness (HP:0003484): Weakness of the muscles of the arms. Evidence: IEA. (OMIM:607791)
- Areflexia (HP:0001284): Absence of neurologic reflexes such as the knee-jerk reaction. Evidence: IEA. (OMIM:607791)
- Distal muscle weakness (HP:0002460): Reduced strength of the musculature of the distal extremities. Evidence: TAS. (OMIM:607791)
- Distal sensory impairment (HP:0002936): An abnormal reduction in sensation in the distal portions of the extremities. Evidence: IEA. (OMIM:607791)
- Segmental peripheral demyelination/remyelination (HP:0003481): A segmental pattern of demyelination and regeneration (remyelination) affecting peripheral nerves. Evidence: TAS. (OMIM:607791)
- Autosomal dominant inheritance (HP:0000006): A mode of inheritance that is observed for traits related to a gene encoded on one of the autosomes (i.e., the human chromosomes 1-22) in which a trait manifests in heterozygotes. In the context of medical genetics, an autosomal dominant disorder is caused when a single copy of the mutant allele is present. Males and females are affected equally, and can both transmit the disorder with a risk of 50% for each child of inheriting the mutant allele. Evidence: IEA. (OMIM:607791)
These phenotypes are associated with the disease Charcot-Marie-Tooth disease dominant intermediate D (OMIM:607791).